Phenotypes associated with the disease Kienbock disease (ORPHA:97332):
- Limitation of joint mobility (HP:0001376): A reduction in the freedom of movement of one or more joints. Evidence: TAS. Frequency: Very frequent (HP:0040281). (ORPHA:97332)
- Bone pain (HP:0002653): An unpleasant sensation characterized by physical discomfort (such as pricking, throbbing, or aching) localized to bone. Evidence: TAS. Frequency: Very frequent (HP:0040281). (ORPHA:97332)
- Osteoarthritis (HP:0002758): Degeneration (wear and tear) of articular cartilage, i.e., of the joint surface. Joint degeneration may be accompanied by osteophytes (bone overgrowth), narrowing of the joint space, regions of sclerosis at the joint surface, or joint deformity. Evidence: TAS. Frequency: Frequent (HP:0040282). (ORPHA:97332)
- Arthralgia (HP:0002829): Joint pain. Evidence: TAS. Frequency: Very frequent (HP:0040281). (ORPHA:97332)
- Abnormality of the wrist (HP:0003019): Abnormality of the wrist, the structure connecting the hand and the forearm. Evidence: TAS. Frequency: Very frequent (HP:0040281). (ORPHA:97332)
- Avascular necrosis (HP:0010885): A disease where there is cellular death (necrosis) of bone components due to interruption of the blood supply. Evidence: TAS. Frequency: Very frequent (HP:0040281). (ORPHA:97332)
- Osteochondritis dissecans (HP:0010886): A joint disorder caused by blood deprivation in the subchondral bone causing the subchondral bone to die in a process called avascular necrosis. The bone is then reabsorbed by the body, leaving the articular cartilage it supported prone to damage. The result is fragmentation (dissection) of both cartilage and bone, and the free movement of these osteochondral fragments within the joint space, causing pain and further damage. Evidence: TAS. Frequency: Very frequent (HP:0040281). (ORPHA:97332)